Phenotypes associated with the disease Scedosporiosis (ORPHA:449280):
- Fever (HP:0001945): Body temperature elevated above the normal range. Evidence: TAS. Frequency: Very frequent (HP:0040281). (ORPHA:449280)
- Immunodeficiency (HP:0002721): Failure of the immune system to protect the body adequately from infection, due to the absence or insufficiency of some component process or substance. Evidence: TAS. Frequency: Very frequent (HP:0040281). (ORPHA:449280)
- Severe infection (HP:0032169): A type of infection that is regarded as a sign of a pathological susceptibility to infection because of unusual severity or intensity of the infection. Evidence: TAS. Frequency: Very frequent (HP:0040281). (ORPHA:449280)
- Opportunistic fungal infection (HP:0032255): An infection that is caused by a fungus that would generally not be able to cause an infection in a host with a normal immune system. Such fungi take advantage of the opportunity, so to speak, that is provided by a weakened immune system. Evidence: TAS. Frequency: Very frequent (HP:0040281). (ORPHA:449280)
- Subcutaneous nodule (HP:0001482): Slightly elevated lesions on or in the skin with a diameter of over 5 mm. Evidence: TAS. Frequency: Frequent (HP:0040282). (ORPHA:449280)
- Pneumonia (HP:0002090): Inflammation of any part of the lung parenchyma. Evidence: TAS. Frequency: Frequent (HP:0040282). (ORPHA:449280)
- Ectopic calcification (HP:0010766): Deposition of calcium salts in a tissue or location in which calcification does not normally occur. Evidence: TAS. Frequency: Frequent (HP:0040282). (ORPHA:449280)
- Unusual skin infection (HP:0032162): Increased susceptibility to infection of the skin, nails, or mucous membranes, as manifested by recurrent or severe cutaneous or mucosal infection, or by skin or mucous membrane infection caused by an atypical or opportunistic organism. Evidence: TAS. Frequency: Frequent (HP:0040282). (ORPHA:449280)
- Pulmonary tuberculosis (HP:0032262): A lung infection by Mycobacterium tuberculosis a slightly curved non-motile, aerobic, non-capsulated and non-spore forming strains of mycobacteria. Evidence: TAS. Frequency: Frequent (HP:0040282). (ORPHA:449280)
- Sinusitis (HP:0000246): Inflammation of the paranasal sinuses owing to a viral, bacterial, or fungal infection, allergy, or an autoimmune reaction. Evidence: TAS. Frequency: Occasional (HP:0040283). (ORPHA:449280)
- Diabetes mellitus (HP:0000819): A group of abnormalities characterized by hyperglycemia and glucose intolerance. Evidence: TAS. Frequency: Occasional (HP:0040283). (ORPHA:449280)
- Pericarditis (HP:0001701): Inflammation of the sac-like covering around the heart (pericardium). Evidence: TAS. Frequency: Occasional (HP:0040283). (ORPHA:449280)
- Abnormal thrombosis (HP:0001977): Venous or arterial thrombosis (formation of blood clots) of spontaneous nature and which cannot be fully explained by acquired risk (e.g. atherosclerosis). Evidence: TAS. Frequency: Occasional (HP:0040283). (ORPHA:449280)
- Pleuritis (HP:0002102): Inflammation of the pleura. Evidence: TAS. Frequency: Occasional (HP:0040283). (ORPHA:449280)
- Hemoptysis (HP:0002105): Coughing up (expectoration) of blood or blood-streaked sputum from the larynx, trachea, bronchi, or lungs. Evidence: TAS. Frequency: Occasional (HP:0040283). (ORPHA:449280)
- Pulmonary fibrosis (HP:0002206): Replacement of normal lung tissues by fibroblasts and collagen. Evidence: TAS. Frequency: Occasional (HP:0040283). (ORPHA:449280)
- Osteomyelitis (HP:0002754): Osteomyelitis is an inflammatory process accompanied by bone destruction and caused by an infecting microorganism. Evidence: TAS. Frequency: Occasional (HP:0040283). (ORPHA:449280)
- Abnormal respiratory system physiology (HP:0002795): Abnormal function of the respiratory system. Evidence: TAS. Frequency: Occasional (HP:0040283). (ORPHA:449280)
- Respiratory failure (HP:0002878): A severe form of respiratory insufficiency characterized by inadequate gas exchange such that the levels of oxygen or carbon dioxide cannot be maintained within normal limits. Evidence: TAS. Frequency: Occasional (HP:0040283). (ORPHA:449280)
- Septic arthritis (HP:0003095). Evidence: TAS. Frequency: Occasional (HP:0040283). (ORPHA:449280)
- Arthralgia/arthritis (HP:0005059). Evidence: TAS. Frequency: Occasional (HP:0040283). (ORPHA:449280)
- Abnormal jejunum morphology (HP:0005265): An abnormality of the jejunum, i.e., of the middle section of the small intestine. Evidence: TAS. Frequency: Occasional (HP:0040283). (ORPHA:449280)
- Unusual CNS infection (HP:0011450): Increased susceptibility to infections of the central nervous system, as manifested by recurrent, severe, or invasive infections involving the brain, meninges, or spinal cord. This can include infections caused by opportunistic or atypical pathogens, or common pathogens presenting with unusual severity or in anatomical locations. Evidence: TAS. Frequency: Occasional (HP:0040283). (ORPHA:449280)
- Pleural empyema (HP:0011919): Accumulation of pus in the pleural cavity. Evidence: TAS. Frequency: Occasional (HP:0040283). (ORPHA:449280)
- Abnormal renal morphology (HP:0012210): Any structural anomaly of the kidney. Evidence: TAS. Frequency: Occasional (HP:0040283). (ORPHA:449280)
- Bronchitis (HP:0012387): Inflammation of the large airways in the lung including any part of the bronchi from the primary bronchi to the tertiary bronchi. Evidence: TAS. Frequency: Occasional (HP:0040283). (ORPHA:449280)
- Cough (HP:0012735): A sudden, audible expulsion of air from the lungs through a partially closed glottis, preceded by inhalation. Evidence: TAS. Frequency: Occasional (HP:0040283). (ORPHA:449280)
- Invasive fungal infection (HP:0020101): Fungal infection characterized by invasion of host tissues. Evidence: TAS. Frequency: Occasional (HP:0040283). (ORPHA:449280)
- Bronchial breath sound (HP:0031994): Bronchial breath sounds contain much higher frequency components than normal breath sounds due to alteration of the low pass filtering function of the alveoli, as occurs in consolidation. It is loud, hollow, and high pitch. Expiratory phase is longer than inspiratory phase with the inspiratory-expiratory ratio (I:E) changing from normal 3:1 to 1:2. There is distinct pause between inspiration and expiration due to absent alveolar phase. It is associated with whispering pectoriloquy. Evidence: TAS. Frequency: Occasional (HP:0040283). (ORPHA:449280)
- Fungal meningitis (HP:0032159): A meningitis caused by fungal infection, with the principal causative organism being Cryptococcus neoformans (cryptococcal meningitis); other causes include Candida and Coccidioides species. A fungal meningitis is most often a manifestation of unusual susceptibility to infection, particularly in severe T-cell deficiencies. Evidence: TAS. Frequency: Occasional (HP:0040283). (ORPHA:449280)
- Apical pulmonary opacity (HP:0032176): An apical cap is a caplike lesion at the lung apex, usually caused by intrapulmonary and pleural fibrosis pulling down extrapleural fat or possibly by chronic ischemia resulting in hyaline plaque formation on the visceral pleura. The prevalence increases with age. It can also be seen in hematoma resulting from aortic rupture or in other fluid collection associated with infection or tumor, either outside the parietal pleura or loculated within the pleural space. Evidence: TAS. Frequency: Occasional (HP:0040283). (ORPHA:449280)
- Endocarditis (HP:0100584): An inflammation of the endocardium, the inner layer of the heart, which usually involves the heart valves. Evidence: TAS. Frequency: Occasional (HP:0040283). (ORPHA:449280)
- Sepsis (HP:0100806): Sepsis is defined as life-threatening organ dysfunction caused by a dysregulated host response to infection. Evidence: TAS. Frequency: Occasional (HP:0040283). (ORPHA:449280)
- Brain imaging abnormality (HP:0410263): An anomaly of metabolism or structure of the brain identified by imaging. Evidence: TAS. Frequency: Occasional (HP:0040283). (ORPHA:449280)